- Generalized-onset seizure (HP:0002197): A generalized-onset seizure is a type of seizure originating at some point within, and rapidly engaging, bilaterally distributed networks. The networks may include cortical and subcortical structures but not necessarily the entire cortex. Evidence: TAS. Frequency: Very frequent (HP:0040281). (ORPHA:36387)
- Generalized non-motor (absence) seizure (HP:0002121): A generalized non-motor (absence) seizure is a type of a type of dialeptic seizure that is of electrographically generalized onset. It is a generalized seizure characterized by an interruption of activities, a blank stare, and usually the person will be unresponsive when spoken to. Any ictal motor phenomena are minor in comparison to these non-motor features. Evidence: TAS. Frequency: Frequent (HP:0040282). (ORPHA:36387)
- Febrile seizure (within the age range of 3 months to 6 years) (HP:0002373): A febrile seizure is any type of seizure (most often a generalized tonic-clonic seizure) occurring with fever (at least 38 degrees Celsius) but in the absence of central nervous system infection, severe metabolic disturbance or other alternative precipitant in children between the ages of 3 months and 6 years. Evidence: TAS. Frequency: Frequent (HP:0040282). (ORPHA:36387)
- Ataxia (HP:0001251): Ataxia refers to impaired coordination of voluntary muscle movement. Cerebellar ataxia refers to ataxia due to dysfunction of the cerebellum. This causes a variety of elementary neurological deficits including asynergy (lack of coordination between muscles, limbs and joints), dysmetria (lack of ability to judge distances that can lead to under- or overshoot in grasping movements), and dysdiadochokinesia (inability to perform rapid movements requiring antagonizing muscle groups to be switched on and off repeatedly). Evidence: TAS. Frequency: Occasional (HP:0040283). (ORPHA:36387)
- Hypotonia (HP:0001252): Hypotonia is an abnormally low muscle tone (the amount of tension or resistance to movement in a muscle). Even when relaxed, muscles have a continuous and passive partial contraction which provides some resistance to passive stretching. Hypotonia thus manifests as diminished resistance to passive stretching. Hypotonia is not the same as muscle weakness, although the two conditions can co-exist. Evidence: TAS. Frequency: Occasional (HP:0040283). (ORPHA:36387)
- Bilateral tonic-clonic seizure (HP:0002069): A bilateral tonic-clonic seizure is a seizure defined by a tonic (bilateral increased tone, lasting seconds to minutes) and then a clonic (bilateral sustained rhythmic jerking) phase. Evidence: TAS. Frequency: Occasional (HP:0040283). (ORPHA:36387)
- Generalized myoclonic seizure (HP:0002123): A generalized myoclonic seizure is a type of generalized motor seizure characterized by bilateral, sudden, brief (<100 ms) involuntary single or multiple contraction of muscles or muscle groups of variable topography (axial, proximal limb, distal). Myoclonus is less regularly repetitive and less sustained than is clonus. Evidence: TAS. Frequency: Occasional (HP:0040283). (ORPHA:36387)
- Incoordination (HP:0002311): A deficit in coordination of muscle movements. Coordination is defined as the orchestrated movement of multiple body parts as required to accomplish intended actions, like walking. Evidence: TAS. Frequency: Occasional (HP:0040283). (ORPHA:36387)
- Developmental regression (HP:0002376): Loss of developmental skills, as manifested by loss of developmental milestones. Evidence: TAS. Frequency: Occasional (HP:0040283). (ORPHA:36387)
- Cortical dysplasia (HP:0002539): The presence of developmental dysplasia of the cerebral cortex. Evidence: TAS. Frequency: Occasional (HP:0040283). (ORPHA:36387)
- Poor fine motor coordination (HP:0007010): An abnormality of the ability (skills) to perform a precise movement of small muscles with the intent to perform a specific act. Fine motor skills are required to mediate movements of the wrists, hands, fingers, feet, and toes. Evidence: TAS. Frequency: Occasional (HP:0040283). (ORPHA:36387)
- Generalized cerebral atrophy/hypoplasia (HP:0007058): Generalized atrophy or hypoplasia of the cerebrum. Evidence: TAS. Frequency: Occasional (HP:0040283). (ORPHA:36387)
- Atonic seizure (HP:0010819): Atonic seizure is a type of motor seizure characterized by a sudden loss or diminution of muscle tone without apparent preceding myoclonic or tonic event lasting about 1 to 2 seconds, involving head, trunk, jaw, or limb musculature. Evidence: TAS. Frequency: Occasional (HP:0040283). (ORPHA:36387)
- EEG with spike-wave complexes (HP:0010850): Complexes of spikes (<70 ms) and sharp waves (70-200 ms), which are sharp transient waves that have a strong association with epilepsy, in cerebral electrical activity recorded along the scalp by electroencephalography (EEG). Evidence: TAS. Frequency: Occasional (HP:0040283). (ORPHA:36387)
- Atypical absence status epilepticus (HP:0011151): Atypical absence status epilepticus is a type of generalized non-convulsive status epilepticus without coma that is semiologically a prolonged atypical absence seizure. Evidence: TAS. Frequency: Occasional (HP:0040283). (ORPHA:36387)
- Cognitive impairment (HP:0100543): Abnormal cognition is characterized by deficits in thinking, reasoning, or remembering. Evidence: TAS. Frequency: Occasional (HP:0040283). (ORPHA:36387)
- Autistic behavior (HP:0000729): Persistent deficits in social interaction and communication and interaction as well as a markedly restricted repertoire of activity and interest as well as repetitive patterns of behavior. Evidence: TAS. Frequency: Very rare (HP:0040284). (ORPHA:36387)
- Anxiety (HP:0000739): Intense feelings of nervousness, tension, or panic often arise in response to interpersonal stresses. There is worry about the negative effects of past unpleasant experiences and future negative possibilities. Individuals may feel fearful, apprehensive, or threatened by uncertainty, and they may also have fears of falling apart or losing control. Evidence: TAS. Frequency: Very rare (HP:0040284). (ORPHA:36387)
- Tremor (HP:0001337): An unintentional, oscillating to-and-fro muscle movement about a joint axis. Evidence: TAS. Frequency: Very rare (HP:0040284). (ORPHA:36387)
- Pes planus (HP:0001763): A foot where the longitudinal arch of the foot is in contact with the ground or floor when the individual is standing; or, in a patient lying supine, a foot where the arch is in contact with the surface of a flat board pressed against the sole of the foot by the examiner with a pressure similar to that expected from weight bearing; or, the height of the arch is reduced. Evidence: TAS. Frequency: Very rare (HP:0040284). (ORPHA:36387)
- Bradykinesia (HP:0002067): Bradykinesia literally means slow movement, and is used clinically to denote a slowness in the execution of movement (in contrast to hypokinesia, which is used to refer to slowness in the initiation of movement). Evidence: TAS. Frequency: Very rare (HP:0040284). (ORPHA:36387)
- Status epilepticus (HP:0002133): Status epilepticus is a type of prolonged seizure resulting either from the failure of the mechanisms responsible for seizure termination or from the initiation of mechanisms which lead to abnormally prolonged seizures (after time point t1). It is a condition that can have long-term consequences (after time point t2), including neuronal death, neuronal injury, and alteration of neuronal networks, depending on the type and duration of seizures. Evidence: TAS. Frequency: Very rare (HP:0040284). (ORPHA:36387)
- Focal impaired awareness seizure (HP:0002384): Focal impaired awareness seizure (or focal seizure with impaired or lost awareness) is a type of focal-onset seizure characterized by some degree (which may be partial) of impairment of the person's awareness of themselves or their surroundings at any point during the seizure. Evidence: TAS. Frequency: Very rare (HP:0040284). (ORPHA:36387)
- Limited knee extension (HP:0003066): Reduced ability to extend (straighten) the knee joint. Evidence: TAS. Frequency: Very rare (HP:0040284). (ORPHA:36387)
- Talipes valgus (HP:0004684): Outward turning of the heel, resulting in clubfoot with the person walking on the inner part of the foot. Evidence: TAS. Frequency: Very rare (HP:0040284). (ORPHA:36387)
- Focal-onset seizure (HP:0007359): A focal-onset seizure is a type of seizure originating within networks limited to one hemisphere. They may be discretely localized or more widely distributed, and may originate in subcortical structures. Evidence: TAS. Frequency: Very rare (HP:0040284). (ORPHA:36387)
- Obsessive-compulsive trait (HP:0008770): The presence of one or more obsessive-compulsive personality traits. Obsessions refer to persistent intrusive thoughts, and compulsions to intrusive behaviors, which the affected person experiences as involuntary, senseless, or repugnant. Evidence: TAS. Frequency: Very rare (HP:0040284). (ORPHA:36387)
- Tibial torsion (HP:0100694): Twisted position of the tibia (shin bone) associated with pathological rotation of the leg. Evidence: TAS. Frequency: Very rare (HP:0040284). (ORPHA:36387)
These phenotypes are associated with the disease Genetic epilepsy with febrile seizure plus (ORPHA:36387).